- Coiled sperm flagella (HP:0032560): Sperm cells whose flagella are twisted (coiled). Evidence: PCS. Frequency: 4/4. (PMID:30811583)
- Male infertility (HP:0003251). Evidence: PCS. Frequency: 4/4. (PMID:30811583)
- Autosomal recessive inheritance (HP:0000007): A mode of inheritance that is observed for traits related to a gene encoded on one of the autosomes (i.e., the human chromosomes 1-22) in which a trait manifests in individuals with two pathogenic alleles, either homozygotes (two copies of the same mutant allele) or compound heterozygotes (whereby each copy of a gene has a distinct mutant allele). Evidence: PCS. (PMID:30811583)
- Reduced sperm motility (HP:0012207): An abnormal reduction in the mobility of ejaculated sperm. Evidence: PCS. Frequency: 4/4. (PMID:30811583)
- Absent sperm flagella (HP:0032558): Sperm cells lacking flagella. Evidence: PCS. Frequency: 4/4. (PMID:30811583)
- Short sperm flagella (HP:0032559): Sperm cells with abnormally short flagella. Evidence: PCS. Frequency: 4/4. (PMID:30811583)
These phenotypes are associated with the disease spermatogenic failure 45 (OMIM:619094).